Phenotypes associated with the disease developmental dysplasia of the hip 4 (OMIM:621311):
- Congenital hip dislocation (HP:0001374). Evidence: PCS. Frequency: 4/4. Onset: Congenital onset (HP:0003577). (PMID:39054052)
- Congenital onset (HP:0003577): A phenotypic abnormality that is present at birth. Evidence: PCS. Frequency: 4/4. (PMID:39054052)
- Hip dysplasia (HP:0001385): The presence of developmental dysplasia of the hip. Evidence: PCS. Frequency: 4/4. Onset: Congenital onset (HP:0003577). (PMID:39054052)
- Autosomal recessive inheritance (HP:0000007): A mode of inheritance that is observed for traits related to a gene encoded on one of the autosomes (i.e., the human chromosomes 1-22) in which a trait manifests in individuals with two pathogenic alleles, either homozygotes (two copies of the same mutant allele) or compound heterozygotes (whereby each copy of a gene has a distinct mutant allele). Evidence: PCS. (PMID:39054052)